Phenotypes associated with the disease Cholera (ORPHA:173):
- Diarrhea (HP:0002014): Abnormally increased frequency (usually defined as three or more) loose or watery bowel movements a day. Evidence: TAS. Frequency: Very frequent (HP:0040281). (ORPHA:173)
- Muscle weakness (HP:0001324): Reduced strength of muscles. Evidence: TAS. Frequency: Frequent (HP:0040282). (ORPHA:173)
- Tachycardia (HP:0001649): A rapid heartrate that exceeds the range of the normal resting heartrate for age. Evidence: TAS. Frequency: Frequent (HP:0040282). (ORPHA:173)
- Acidosis (HP:0001941): Abnormal acid accumulation or depletion of base. Evidence: TAS. Frequency: Frequent (HP:0040282). (ORPHA:173)
- Dehydration (HP:0001944). Evidence: TAS. Frequency: Frequent (HP:0040282). (ORPHA:173)
- Vomiting (HP:0002013): Forceful ejection of the contents of the stomach through the mouth by means of a series of involuntary spasmic contractions. Evidence: TAS. Frequency: Frequent (HP:0040282). (ORPHA:173)
- Hypotension (HP:0002615): Low Blood Pressure, vascular hypotension. Evidence: TAS. Frequency: Frequent (HP:0040282). (ORPHA:173)
- Hypokalemia (HP:0002900): The concentration of potassium(1+) in the blood circulation is below the lower limit of normal. Evidence: TAS. Frequency: Frequent (HP:0040282). (ORPHA:173)
- Hypocalcemia (HP:0002901): The concentration of calcium in the blood circulation is below the lower limit of normal. Evidence: TAS. Frequency: Frequent (HP:0040282). (ORPHA:173)
- Hyponatremia (HP:0002902): The concentration of sodium in the blood circulation is below the lower limit of normal. Evidence: TAS. Frequency: Frequent (HP:0040282). (ORPHA:173)
- Abnormal circulating electrolyte concentration (HP:0003111): Abnormality of the homeostasis (concentration) of a monoatomic ion. Evidence: TAS. Frequency: Frequent (HP:0040282). (ORPHA:173)
- Muscle spasm (HP:0003394): Sudden and involuntary contractions of one or more muscles. Evidence: TAS. Frequency: Frequent (HP:0040282). (ORPHA:173)
- Abnormality of renal excretion (HP:0011036): An altered ability of the kidneys to void urine and/or specific substances. Evidence: TAS. Frequency: Frequent (HP:0040282). (ORPHA:173)
- Decreased urine output (HP:0011037): A decreased rate of urine production. Evidence: TAS. Frequency: Frequent (HP:0040282). (ORPHA:173)
- Deeply set eye (HP:0000490): An eye that is more deeply recessed into the plane of the face than is typical. Evidence: TAS. Frequency: Occasional (HP:0040283). (ORPHA:173)
- Irritability (HP:0000737): An emotional state characterized by negative feelings of heightened frustration, annoyance, or feeling upset, often triggered by internal factors (e.g., fatigue, hunger, unfulfilled desires) or external factors (e.g., social or environmental challenges). Irritability may be unpredictable, and is accompanied by a lowered threshold for emotional reactivity and observable features (speech, facial expressions, or psychomotor activity). Evidence: TAS. Frequency: Occasional (HP:0040283). (ORPHA:173)
- Seizure (HP:0001250): A seizure is an intermittent abnormality of nervous system physiology characterized by a transient occurrence of signs and/or symptoms due to abnormal excessive or synchronous neuronal activity in the brain. Evidence: TAS. Frequency: Occasional (HP:0040283). (ORPHA:173)
- Lethargy (HP:0001254): A state of fatigue, either physical or mental slowness and sluggishness, with difficulties in initiating or performing simple tasks. Distinguished from apathy which implies indifference and a lack of desire or interest in the task. A person with lethargy may have the desire, but not the energy to engage in personal or socially relevant tasks. Evidence: TAS. Frequency: Occasional (HP:0040283). (ORPHA:173)
- Premature birth (HP:0001622): The birth of a baby of less than 37 weeks of gestational age. Evidence: TAS. Frequency: Occasional (HP:0040283). (ORPHA:173)
- Acute kidney injury (HP:0001919): Sudden loss of renal function, as manifested by decreased urine production, and a rise in serum creatinine or blood urea nitrogen concentration (azotemia). Evidence: TAS. Frequency: Occasional (HP:0040283). (ORPHA:173)
- Hypoglycemia (HP:0001943): A decreased concentration of glucose in the blood. Evidence: TAS. Frequency: Occasional (HP:0040283). (ORPHA:173)
- Abdominal pain (HP:0002027): An unpleasant sensation characterized by physical discomfort (such as pricking, throbbing, or aching) and perceived to originate in the abdomen. Evidence: TAS. Frequency: Occasional (HP:0040283). (ORPHA:173)
- Tachypnea (HP:0002789): Very rapid breathing. Evidence: TAS. Frequency: Occasional (HP:0040283). (ORPHA:173)
- Hyperventilation (HP:0002883): Hyperventilation refers to an increased pulmonary ventilation rate that is faster than necessary for the exchange of gases. Hyperventilation can result from increased frequency of breathing, an increased tidal volume, or both, and leads to an excess intake of oxygen and the blowing off of carbon dioxide. Evidence: TAS. Frequency: Occasional (HP:0040283). (ORPHA:173)
- Lactic acidosis (HP:0003128): An abnormal buildup of lactic acid in the body, leading to acidification of the blood and other bodily fluids. Evidence: TAS. Frequency: Occasional (HP:0040283). (ORPHA:173)
- Miscarriage (HP:0005268): A pregnancy that ends at a stage in which the fetus is incapable of surviving on its own, defined as the spontaneous loss of a fetus before the 22th week of pregnancy. Evidence: TAS. Frequency: Occasional (HP:0040283). (ORPHA:173)
- Loss of consciousness (HP:0007185): Loss of awareness of oneself or one's surroundings, involving (i) a loss of normal motor control is evident as flaccidity or stiffness, either of which can be accompanied by jerking movements, and postural control is lost so that patients fall if they are in an upright position; (ii) normal responsiveness is lost; and (iii) the patient experiences amnesia for the event. Loss of consciousness my be transitory (e.g., syncope) or prolonged. Evidence: TAS. Frequency: Occasional (HP:0040283). (ORPHA:173)
- Palmoplantar cutis laxa (HP:0007517): Loose, wrinkled skin of hands and feet. Evidence: TAS. Frequency: Occasional (HP:0040283). (ORPHA:173)
- Hypovolemic shock (HP:0031274): A state of shock characterized by decreased circulating blood volume in relation to total vascular capacity. This type of shock is characterized by a reduction of diastolic filling pressures. Evidence: TAS. Frequency: Occasional (HP:0040283). (ORPHA:173)
- Abdominal cramps (HP:0032155): A type of abdominal pain characterized by a feeling of contractions and typically fluctuating in intensity. Evidence: TAS. Frequency: Occasional (HP:0040283). (ORPHA:173)
- Achlorhydria (HP:0032448): A condition in which production of hydrochloric acid in the stomach is absent. Evidence: TAS. Frequency: Occasional (HP:0040283). (ORPHA:173)
- Stroke (HP:0001297): Sudden impairment of blood flow to a part of the brain due to occlusion or rupture of an artery to the brain. Evidence: TAS. Frequency: Very rare (HP:0040284). (ORPHA:173)
- Fever (HP:0001945): Body temperature elevated above the normal range. Evidence: TAS. Frequency: Very rare (HP:0040284). (ORPHA:173)
- Aspiration pneumonia (HP:0011951): Pneumonia due to the aspiration (breathing in) of food, liquid, or gastric contents into the upper respiratory tract. Evidence: TAS. Frequency: Very rare (HP:0040284). (ORPHA:173)